Phenotypes associated with the disease cataract 8 multiple types (OMIM:115665):
- Nuclear cataract (HP:0100018): A nuclear cataract is an opacity or clouding that develops in the lens nucleus. That is, a nuclear cataract is one that is located in the center of the lens. The nucleus tends to darken changing from clear to yellow and sometimes brown. Evidence: PCS. Frequency: 41/41. Onset: Congenital onset (HP:0003577). (PMID:7607651)
- Progressive visual loss (HP:0000529): A reduction of previously attained ability to see. Evidence: PCS. (PMID:7607651)
- Developmental cataract (HP:0000519): A cataract that occurs congenitally as the result of a developmental defect, in contrast to the majority of cataracts that occur in adulthood as the result of degenerative changes of the lens. Evidence: TAS. (OMIM:115665)
- Autosomal dominant inheritance (HP:0000006): A mode of inheritance that is observed for traits related to a gene encoded on one of the autosomes (i.e., the human chromosomes 1-22) in which a trait manifests in heterozygotes. In the context of medical genetics, an autosomal dominant disorder is caused when a single copy of the mutant allele is present. Males and females are affected equally, and can both transmit the disorder with a risk of 50% for each child of inheriting the mutant allele. Evidence: PCS. (OMIM:115665)